Phenotypes associated with the disease pulmonary edema of mountaineers, susceptibility to (OMIM:178400):
- Pulmonary edema (HP:0100598): Fluid accumulation in the lungs. Evidence: IEA. (OMIM:178400)
- Edema (HP:0000969): An abnormal accumulation of fluid beneath the skin, or in one or more cavities of the body. Evidence: IEA. (OMIM:178400)
- Abnormality of the respiratory system (HP:0002086): An abnormality of the respiratory system, which include the airways, lungs, and the respiratory muscles. Evidence: IEA. (OMIM:178400)
- Elevated pulmonary artery pressure (HP:0004890): An abnormally elevated blood pressure in the circulation of the pulmonary artery. Evidence: IEA. (OMIM:178400)
- Autosomal dominant inheritance (HP:0000006): A mode of inheritance that is observed for traits related to a gene encoded on one of the autosomes (i.e., the human chromosomes 1-22) in which a trait manifests in heterozygotes. In the context of medical genetics, an autosomal dominant disorder is caused when a single copy of the mutant allele is present. Males and females are affected equally, and can both transmit the disorder with a risk of 50% for each child of inheriting the mutant allele. Evidence: IEA. (OMIM:178400)